- Abnormality of the uterus (HP:0000130): An abnormality of the uterus. Evidence: TAS. (OMIM:192000)
- Bicornuate uterus (HP:0000813): The presence of a bicornuate uterus. Evidence: TAS. (OMIM:192000)
- Autosomal dominant inheritance (HP:0000006): A mode of inheritance that is observed for traits related to a gene encoded on one of the autosomes (i.e., the human chromosomes 1-22) in which a trait manifests in heterozygotes. In the context of medical genetics, an autosomal dominant disorder is caused when a single copy of the mutant allele is present. Males and females are affected equally, and can both transmit the disorder with a risk of 50% for each child of inheriting the mutant allele. Evidence: TAS. (OMIM:192000)
These phenotypes are associated with the disease uterine anomalies (OMIM:192000).